- Macrodactyly of finger (HP:0100746): A type of Macrodactyly affecting one or several fingers. Evidence: TAS. Frequency: Obligate (HP:0040280). (ORPHA:295044)
- Exostoses of hand bones (HP:0004276): Abnormal formation of new bone on the surface of a bone of the hand. Evidence: TAS. Frequency: Frequent (HP:0040282). (ORPHA:295044)
- Abnormal hand morphology (HP:0005922): Any structural anomaly of the hand. Evidence: TAS. Frequency: Frequent (HP:0040282). (ORPHA:295044)
- Hyperostosis (HP:0100774): Excessive growth or abnormal thickening of bone tissue. Evidence: TAS. Frequency: Frequent (HP:0040282). (ORPHA:295044)
- Finger syndactyly (HP:0006101): Webbing or fusion of the fingers, involving soft parts only or including bone structure. Bony fusions are referred to as "bony" Syndactyly if the fusion occurs in a radio-ulnar axis. Fusions of bones of the fingers in a proximo-distal axis are referred to as "Symphalangism". Evidence: TAS. Frequency: Occasional (HP:0040283). (ORPHA:295044)
- Long metacarpals (HP:0010493): An abnormally increased length of the metacarpal bones. Evidence: TAS. Frequency: Occasional (HP:0040283). (ORPHA:295044)
- Constrictive median neuropathy (HP:0012185): Injury to the median nerve caused by its entrapment at the wrist as it traverses through the carpal tunnel. Clinically, constrictive median neuropathy is characterized by pain, paresthesia, and weakness in the median nerve distribution of the hand. Evidence: TAS. Frequency: Occasional (HP:0040283). (ORPHA:295044)
- Entrapment neuropathy of the ulnar nerve at elbow (HP:0012186): An entrapment neuropathy of the ulnar nerve in the cubital tunnel (in the elbow) characterized by numbness in the ring and little fingers and weakness of the intrinsic muscles in the hand. Evidence: TAS. Frequency: Occasional (HP:0040283). (ORPHA:295044)
These phenotypes are associated with the disease Macrodactyly of fingers (ORPHA:295044).